Phenotypes associated with the disease rolandic epilepsy, intellectual disability, and speech dyspraxia, X-linked (OMIM:300643):
- Bilateral perisylvian polymicrogyria (HP:0032407): A type of perisylvian polymicrogyria that affects both sides of the brain. Evidence: IEA. (PMID:16497722)
- Mild intellectual disability (HP:0001256): Mild intellectual disability (ID) is defined as a type of ID characterized by mildly sub-average adaptive functioning and intellectual functioning, with an intelligence quotient (IQ) the range of 50-69. Evidence: IEA. (OMIM:300643)
- Seizure (HP:0001250): A seizure is an intermittent abnormality of nervous system physiology characterized by a transient occurrence of signs and/or symptoms due to abnormal excessive or synchronous neuronal activity in the brain. Evidence: IEA. (OMIM:300643)
- Speech apraxia (HP:0011098): A type of apraxia that is characterized by difficulty or inability to execute speech movements because of problems with coordination and motor problems, leading to incorrect articulation. An increase of errors with increasing word and phrase length may occur. Evidence: IEA. (OMIM:300643)
- Focal-onset seizure (HP:0007359): A focal-onset seizure is a type of seizure originating within networks limited to one hemisphere. They may be discretely localized or more widely distributed, and may originate in subcortical structures. Evidence: IEA. (OMIM:300643)
- Autosomal dominant inheritance (HP:0000006): A mode of inheritance that is observed for traits related to a gene encoded on one of the autosomes (i.e., the human chromosomes 1-22) in which a trait manifests in heterozygotes. In the context of medical genetics, an autosomal dominant disorder is caused when a single copy of the mutant allele is present. Males and females are affected equally, and can both transmit the disorder with a risk of 50% for each child of inheriting the mutant allele. Evidence: IEA. (PMID:16497722)